Phenotypes associated with the disease focal segmental glomerulosclerosis 4, susceptibility to (OMIM:612551):
- Stage 5 chronic kidney disease (HP:0003774): A degree of kidney failure severe enough to require dialysis or kidney transplantation for survival characterized by a severe reduction in glomerular filtration rate (less than 15 ml/min/1.73 m2) and other manifestations including increased serum creatinine. Evidence: PCS. (PMID:20647424)
- Focal segmental glomerulosclerosis (HP:0000097): Segmental accumulation of scar tissue in individual (but not all) glomeruli. Evidence: PCS. (PMID:20647424)
- Polygenic inheritance (HP:0010982): A mode of inheritance that depends on a mixture of major and minor genetic determinants possibly together with environmental factors. Diseases inherited in this manner are termed complex diseases. Evidence: PCS. (PMID:20647424)